Phenotypes associated with the disease Hemiparkinsonism-hemiatrophy syndrome (ORPHA:306669):
- Dysarthria (HP:0001260): Dysarthric speech is a general description referring to a neurological speech disorder characterized by poor articulation. Depending on the involved neurological structures, dysarthria may be further classified as spastic, flaccid, ataxic, hyperkinetic and hypokinetic, or mixed. Evidence: TAS. Frequency: Frequent (HP:0040282). (ORPHA:306669)
- Hemiparesis (HP:0001269): Loss of strength in the arm, leg, and sometimes face on one side of the body. Hemiplegia refers to a complete loss of strength, whereas hemiparesis refers to an incomplete loss of strength. Evidence: TAS. Frequency: Frequent (HP:0040282). (ORPHA:306669)
- Generalized hypotonia (HP:0001290): Generalized muscular hypotonia (abnormally low muscle tone). Evidence: TAS. Frequency: Frequent (HP:0040282). (ORPHA:306669)
- Parkinsonism (HP:0001300): Characteristic neurologic anomaly resulting from degeneration of dopamine-generating cells in the substantia nigra, a region of the midbrain, characterized clinically by shaking, rigidity, slowness of movement and difficulty with walking and gait. Evidence: TAS. Frequency: Frequent (HP:0040282). (ORPHA:306669)
- Dystonia (HP:0001332): An abnormally increased muscular tone that causes fixed abnormal postures. There is a slow, intermittent twisting motion that leads to exaggerated turning and posture of the extremities and trunk. Evidence: TAS. Frequency: Frequent (HP:0040282). (ORPHA:306669)
- Tremor (HP:0001337): An unintentional, oscillating to-and-fro muscle movement about a joint axis. Evidence: TAS. Frequency: Frequent (HP:0040282). (ORPHA:306669)
- Bradykinesia (HP:0002067): Bradykinesia literally means slow movement, and is used clinically to denote a slowness in the execution of movement (in contrast to hypokinesia, which is used to refer to slowness in the initiation of movement). Evidence: TAS. Frequency: Frequent (HP:0040282). (ORPHA:306669)
- Hyperactive deep tendon reflexes (HP:0006801). Evidence: TAS. Frequency: Frequent (HP:0040282). (ORPHA:306669)
- Lateral ventricle dilatation (HP:0006956). Evidence: TAS. Frequency: Frequent (HP:0040282). (ORPHA:306669)
- Hemifacial atrophy (HP:0011331): Unilateral atrophy of facial tissues, including muscles, bones and skin. Evidence: TAS. Frequency: Frequent (HP:0040282). (ORPHA:306669)
- Brain atrophy (HP:0012444): Partial or complete wasting (loss) of brain tissue that was once present. Evidence: TAS. Frequency: Frequent (HP:0040282). (ORPHA:306669)
- Neonatal asphyxia (HP:0012768): Respiratory failure in the newborn. Evidence: TAS. Frequency: Frequent (HP:0040282). (ORPHA:306669)
- Hemiatrophy (HP:0100556): Undergrowth of the limbs that affects only one side. Evidence: TAS. Frequency: Frequent (HP:0040282). (ORPHA:306669)
- Depression (HP:0000716): Frequently experiencing feelings of being down, miserable, and/or hopeless; struggling to recover from these moods; having a pessimistic outlook on the future; feeling a pervasive sense of shame; having a low self-worth; experiencing thoughts of suicide and engaging in suicidal behavior. Evidence: TAS. Frequency: Occasional (HP:0040283). (ORPHA:306669)
- Gait disturbance (HP:0001288): The term gait disturbance can refer to any disruption of the ability to walk. Evidence: TAS. Frequency: Occasional (HP:0040283). (ORPHA:306669)
- Scoliosis (HP:0002650): The presence of an abnormal lateral curvature of the spine. Evidence: TAS. Frequency: Occasional (HP:0040283). (ORPHA:306669)
- Cerebral cortical hemiatrophy (HP:0100308): Atrophy of one side of the brain, characterized by findings including thinning of the cerebral cortex, reduced volume of the cerebral white matter with abnormal myelination, and enlargement of the ispilateral fourth ventricle. Evidence: TAS. Frequency: Occasional (HP:0040283). (ORPHA:306669)